Phenotypes associated with the disease Late-onset familial hypoaldosteronism (ORPHA:556037):
- Increased circulating renin concentration (HP:0000848): An increased level of renin in the blood. Evidence: TAS. Frequency: Occasional (HP:0040283). (ORPHA:556037)
- Orthostatic hypotension (HP:0001278): A form of hypotension characterized by a sudden fall in blood pressure that occurs when a person assumes a standing position. Evidence: TAS. Frequency: Occasional (HP:0040283). (ORPHA:556037)
- Fever (HP:0001945): Body temperature elevated above the normal range. Evidence: TAS. Frequency: Occasional (HP:0040283). (ORPHA:556037)
- Vomiting (HP:0002013): Forceful ejection of the contents of the stomach through the mouth by means of a series of involuntary spasmic contractions. Evidence: TAS. Frequency: Occasional (HP:0040283). (ORPHA:556037)
- Hyperkalemia (HP:0002153): The concentration of potassium(1+) in the blood circulation is above the upper limit of normal. Evidence: TAS. Frequency: Occasional (HP:0040283). (ORPHA:556037)
- Hypotension (HP:0002615): Low Blood Pressure, vascular hypotension. Evidence: TAS. Frequency: Occasional (HP:0040283). (ORPHA:556037)
- Hyponatremia (HP:0002902): The concentration of sodium in the blood circulation is below the lower limit of normal. Evidence: TAS. Frequency: Occasional (HP:0040283). (ORPHA:556037)
- Decreased circulating aldosterone concentration (HP:0004319): Abnormally reduced levels of aldosterone. Evidence: TAS. Frequency: Occasional (HP:0040283). (ORPHA:556037)
- Abnormal circulating corticosterone level (HP:0012112): An abnormality of the concentration of corticosterone in the blood. Evidence: TAS. Frequency: Occasional (HP:0040283). (ORPHA:556037)
- Renal sodium wasting (HP:0012606): An abnormally increased sodium concentration in the urine in the presence of hyponatremia. Evidence: TAS. Frequency: Occasional (HP:0040283). (ORPHA:556037)
- Elevated serum 11-deoxycortisol (HP:0025436): Increased concentration of 11-deoxycortisol in the circulation. 11-deoxycorticosterone, which is also known as simply deoxycorticosterone and 21-hydroxyprogesterone, is a steroid hormore that is produces in the adrenals and is a precursor to aldosterone. Evidence: TAS. Frequency: Occasional (HP:0040283). (ORPHA:556037)
- Failure to thrive (HP:0001508): Failure to thrive (FTT) refers to a child whose physical growth is substantially below the norm. Evidence: TAS. Frequency: Very rare (HP:0040284). (ORPHA:556037)
- Postnatal growth retardation (HP:0008897): Slow or limited growth after birth. Evidence: TAS. Frequency: Very rare (HP:0040284). (ORPHA:556037)
Not associated with this disease:
- Abnormal external genitalia morphology (HP:0000811): A structural anomaly of the external genitalia. Evidence: TAS. (ORPHA:556037)